- Intellectual disability (HP:0001249): The term intellectual disability or intellectual developmental disorder is used to describe significantly sub-average intellectual and adaptive functioning based on clinical assessment and as measured by individually administered, appropriately normed, standardized and validated tests of intellectual functioning and adaptive behavior, with onset during the developmental period from infancy through adolescence. Evidence: TAS. Frequency: Frequent (HP:0040282). (ORPHA:2940)
- Seizure (HP:0001250): A seizure is an intermittent abnormality of nervous system physiology characterized by a transient occurrence of signs and/or symptoms due to abnormal excessive or synchronous neuronal activity in the brain. Evidence: TAS. Frequency: Frequent (HP:0040282). (ORPHA:2940)
- Spasticity (HP:0001257): A motor disorder characterized by a velocity-dependent increase in tonic stretch reflexes with increased muscle tone, exaggerated (hyperexcitable) tendon reflexes. Evidence: TAS. Frequency: Very frequent (HP:0040281). (ORPHA:2940)
- Ventriculomegaly (HP:0002119): An increase in size of the ventricular system of the brain. Evidence: TAS. Frequency: Very frequent (HP:0040281). (ORPHA:2940)
- Porencephalic cyst (HP:0002132): A cavity within the cerebral hemisphere, filled with cerebrospinal fluid, that communicates directly with the ventricular system. Evidence: TAS. Frequency: Very frequent (HP:0040281). (ORPHA:2940)
- Hemiplegia/hemiparesis (HP:0004374): Loss of strength in the arm, leg, and sometimes face on one side of the body. Hemiplegia refers to a severe or complete loss of strength, whereas hemiparesis refers to a relatively mild loss of strength. Evidence: TAS. Frequency: Frequent (HP:0040282). (ORPHA:2940)
- Cerebral palsy (HP:0100021): Cerebral palsy describes a group of permanent disorders of the development of movement and posture, causing activity limitation, that are attributed to nonprogressive disturbances that occurred in the developing fetal or infant brain. The motor disorders of cerebral palsy are often accompanied by disturbances of sensation, perception, cognition, communication, and behavior, by epilepsy, and by secondary musculoskeletal problems. Evidence: TAS. Frequency: Frequent (HP:0040282). (ORPHA:2940)
- Abnormality of movement (HP:0100022): An abnormality of movement with a neurological basis characterized by changes in coordination and speed of voluntary movements. Evidence: TAS. Frequency: Very frequent (HP:0040281). (ORPHA:2940)
These phenotypes are associated with the disease Porencephaly (ORPHA:2940).